Phenotypes associated with the disease Cerebellar ataxia, Cayman type (ORPHA:94122):
- Nonprogressive cerebellar ataxia (HP:0002470). Evidence: TAS. Frequency: Very frequent (HP:0040281). (ORPHA:94122)
- Nystagmus (HP:0000639): Rhythmic, involuntary oscillations of one or both eyes related to abnormality in fixation, conjugate gaze, or vestibular mechanisms. Evidence: TAS. Frequency: Frequent (HP:0040282). (ORPHA:94122)
- Dysarthria (HP:0001260): Dysarthric speech is a general description referring to a neurological speech disorder characterized by poor articulation. Depending on the involved neurological structures, dysarthria may be further classified as spastic, flaccid, ataxic, hyperkinetic and hypokinetic, or mixed. Evidence: TAS. Frequency: Frequent (HP:0040282). (ORPHA:94122)
- Global developmental delay (HP:0001263): A delay in the achievement of motor or mental milestones in the domains of development of a child, including motor skills, speech and language, cognitive skills, and social and emotional skills. This term should only be used to describe children younger than five years of age. Evidence: TAS. Frequency: Frequent (HP:0040282). (ORPHA:94122)
- Generalized hypotonia (HP:0001290): Generalized muscular hypotonia (abnormally low muscle tone). Evidence: TAS. Frequency: Frequent (HP:0040282). (ORPHA:94122)
- Cerebellar hypoplasia (HP:0001321): Cerebellar hypoplasia is a descriptive term implying a cerebellum with a reduced volume, but a normal shape and is stable over time. Evidence: TAS. Frequency: Frequent (HP:0040282). (ORPHA:94122)
- Gait ataxia (HP:0002066): A type of ataxia characterized by the impairment of the ability to coordinate the movements required for normal walking. Gait ataxia is characteirzed by a wide-based staggering gait with a tendency to fall. Evidence: TAS. Frequency: Frequent (HP:0040282). (ORPHA:94122)
- Truncal ataxia (HP:0002078): Truncal ataxia is a sign of ataxia characterized by instability of the trunk. It usually occurs during sitting. Evidence: TAS. Frequency: Frequent (HP:0040282). (ORPHA:94122)
- Intention tremor (HP:0002080): A type of kinetic tremor that occurs during target directed movement is called intention tremor. That is, an oscillatory cerebellar ataxia that tends to be absent when the limbs are inactive and during the first part of voluntary movement but worsening as the movement continues and greater precision is required (e.g., in touching a target such as the patient's nose or a physician's finger). Evidence: TAS. Frequency: Frequent (HP:0040282). (ORPHA:94122)
- Broad-based gait (HP:0002136): An abnormal gait pattern in which persons stand and walk with their feet spaced widely apart. This is often a component of cerebellar ataxia. Evidence: TAS. Frequency: Frequent (HP:0040282). (ORPHA:94122)
Not associated with this disease:
- Abnormal retinal morphology (HP:0000479): A structural abnormality of the retina. Evidence: TAS. (ORPHA:94122)